- Amelogenesis imperfecta (HP:0000705): A developmental dysplasia of the dental enamel. Evidence: PCS. (PMID:24305999)
- Anterior open-bite malocclusion (HP:0009102): Anterior open bite is a malocclusion characterized by a gap between the anterior teeth (incisors), that is, by a deficiency in the normal vertical overlap between antagonist incisal edges when the posterior teeth are in occlusion. Evidence: PCS. Frequency: 12/20. (PMID:24305999;OMIM:616221)
- Enamel hypoplasia (HP:0006297): Developmental hypoplasia of the dental enamel. Evidence: PCS. (PMID:24305999)
- Yellow-brown discoloration of the teeth (HP:0006286). Evidence: PCS. (PMID:24305999)
- Autosomal recessive inheritance (HP:0000007): A mode of inheritance that is observed for traits related to a gene encoded on one of the autosomes (i.e., the human chromosomes 1-22) in which a trait manifests in individuals with two pathogenic alleles, either homozygotes (two copies of the same mutant allele) or compound heterozygotes (whereby each copy of a gene has a distinct mutant allele). Evidence: PCS. (PMID:24305999)
- Dental enamel pits (HP:0009722): The presence of small depressions in the dental enamel. Evidence: PCS. (PMID:24319098)
These phenotypes are associated with the disease amelogenesis imperfecta type 1H (OMIM:616221).